- Hearing impairment (HP:0000365): A decreased magnitude of the sensory perception of sound. Evidence: IEA. Frequency: Obligate (HP:0040280). (OMIM:602459)
- Autosomal dominant inheritance (HP:0000006): A mode of inheritance that is observed for traits related to a gene encoded on one of the autosomes (i.e., the human chromosomes 1-22) in which a trait manifests in heterozygotes. In the context of medical genetics, an autosomal dominant disorder is caused when a single copy of the mutant allele is present. Males and females are affected equally, and can both transmit the disorder with a risk of 50% for each child of inheriting the mutant allele. Evidence: IEA. (OMIM:602459)
These phenotypes are associated with the disease autosomal dominant nonsyndromic hearing loss 15 (OMIM:602459).